Phenotypes associated with the disease Bronchogenic cyst (ORPHA:2357):
- Bronchogenic cyst (HP:0100730): A rare congenital cystic lesion of the lungs in the mediastinum. Evidence: TAS. Frequency: Obligate (HP:0040280). (ORPHA:2357)
- Abnormal pulmonary thoracic imaging finding (HP:0031983): This term groups terms representing abnormal findings derived from chest X-ray investigation of the lung. In general, lung abnormalities can manifest as opacities (areas of increased density) or as regions with decreased density. Evidence: TAS. Frequency: Frequent (HP:0040282). (ORPHA:2357)
- Abnormal mediastinum morphology (HP:0045026): Any structural anomaly of the central compartment of the thoracic cavity. Evidence: TAS. Frequency: Frequent (HP:0040282). (ORPHA:2357)
- Fever (HP:0001945): Body temperature elevated above the normal range. Evidence: TAS. Frequency: Occasional (HP:0040283). (ORPHA:2357)
- Abnormal esophagus morphology (HP:0002031): A structural abnormality of the esophagus. Evidence: TAS. Frequency: Occasional (HP:0040283). (ORPHA:2357)
- Pneumonia (HP:0002090): Inflammation of any part of the lung parenchyma. Evidence: TAS. Frequency: Occasional (HP:0040283). (ORPHA:2357)
- Dyspnea (HP:0002094): Difficult or labored breathing. Dyspnea is a subjective feeling only the patient can rate, e.g., on a Borg scale. Evidence: TAS. Frequency: Occasional (HP:0040283). (ORPHA:2357)
- Abnormality of the cervical spine (HP:0003319): Any abnormality of the cervical vertebral column. Evidence: TAS. Frequency: Occasional (HP:0040283). (ORPHA:2357)
- Cough (HP:0012735): A sudden, audible expulsion of air from the lungs through a partially closed glottis, preceded by inhalation. Evidence: TAS. Frequency: Occasional (HP:0040283). (ORPHA:2357)
- Chronic infection (HP:0031035): Presence of a protracted or persistent infection by a pathogen potentially related to an underlying abnormality of the immune system that is not able to clear the infection. Evidence: TAS. Frequency: Occasional (HP:0040283). (ORPHA:2357)
- Abnormal sputum (HP:0032016): Abnormal appearance of material expectorated (coughed up) from the respiratory system and that is composed of mucus but may contain other substances such as pus, blood, microorganisms, and fibrin. Evidence: TAS. Frequency: Occasional (HP:0040283). (ORPHA:2357)
- Pulmonary cyst (HP:0032445): A round circumscribed space within a lung that is surrounded by an epithelial or fibrous wall of variable thickness. A cyst usually has a thin and regular wall (less than 2 mm) and contains air, although some may contain fluid. Evidence: TAS. Frequency: Occasional (HP:0040283). (ORPHA:2357)
- Chest pain (HP:0100749): An unpleasant sensation characterized by physical discomfort (such as pricking, throbbing, or aching) localized to the chest. Evidence: TAS. Frequency: Occasional (HP:0040283). (ORPHA:2357)
- Abnormality of the neck (HP:0000464): An abnormality of the neck. Evidence: TAS. Frequency: Very rare (HP:0040284). (ORPHA:2357)
- Abnormality of the diaphragm (HP:0000775): Any abnormality of the diaphragm, the sheet of skeletal muscle that separates the thoracic cavity from the abdominal cavity. Evidence: TAS. Frequency: Very rare (HP:0040284). (ORPHA:2357)
- Muscle weakness (HP:0001324): Reduced strength of muscles. Evidence: TAS. Frequency: Very rare (HP:0040284). (ORPHA:2357)
- Abnormal myocardium morphology (HP:0001637): A structural anomaly of the muscle layer of the heart wall. Evidence: TAS. Frequency: Very rare (HP:0040284). (ORPHA:2357)
- Abnormal pericardium morphology (HP:0001697): An abnormality of the pericardium, i.e., of the fluid filled sac that surrounds the heart and the proximal ends of the aorta, vena cava, and the pulmonary artery. Evidence: TAS. Frequency: Very rare (HP:0040284). (ORPHA:2357)
- Dysphagia (HP:0002015): Difficulty in swallowing. Evidence: TAS. Frequency: Very rare (HP:0040284). (ORPHA:2357)
- Abdominal pain (HP:0002027): An unpleasant sensation characterized by physical discomfort (such as pricking, throbbing, or aching) and perceived to originate in the abdomen. Evidence: TAS. Frequency: Very rare (HP:0040284). (ORPHA:2357)
- Abnormal pleura morphology (HP:0002103): An abnormality of the pulmonary pleura, the thin, transparent membrane which covers the lungs and lines the inside of the chest walls. Evidence: TAS. Frequency: Very rare (HP:0040284). (ORPHA:2357)
- Hemoptysis (HP:0002105): Coughing up (expectoration) of blood or blood-streaked sputum from the larynx, trachea, bronchi, or lungs. Evidence: TAS. Frequency: Very rare (HP:0040284). (ORPHA:2357)
- Headache (HP:0002315): Cephalgia, or pain sensed in various parts of the head, not confined to the area of distribution of any nerve. Evidence: TAS. Frequency: Very rare (HP:0040284). (ORPHA:2357)
- Abnormal stomach morphology (HP:0002577): An abnormality of the stomach. Evidence: TAS. Frequency: Very rare (HP:0040284). (ORPHA:2357)
- Abnormal peritoneum morphology (HP:0002585): An abnormality of the peritoneum. Evidence: TAS. Frequency: Very rare (HP:0040284). (ORPHA:2357)
- Abnormal foramen magnum morphology (HP:0002699): Any abnormality of the foramen magnum. Evidence: TAS. Frequency: Very rare (HP:0040284). (ORPHA:2357)
- Syringomyelia (HP:0003396): Dilated, glial-lined cavity in spinal cord. This cavity does not communicate with the central canal, and usually is between the dorsal columns unilaterally or bilaterally along the side of the cord. Evidence: TAS. Frequency: Very rare (HP:0040284). (ORPHA:2357)
- Paresthesia (HP:0003401): Abnormal sensations such as tingling, pricking, or numbness of the skin with no apparent physical cause. Evidence: TAS. Frequency: Very rare (HP:0040284). (ORPHA:2357)
- Back pain (HP:0003418): An unpleasant sensation characterized by physical discomfort (such as pricking, throbbing, or aching) localized to the back. Evidence: TAS. Frequency: Very rare (HP:0040284). (ORPHA:2357)
- Ectopic calcification (HP:0010766): Deposition of calcium salts in a tissue or location in which calcification does not normally occur. Evidence: TAS. Frequency: Very rare (HP:0040284). (ORPHA:2357)
- Neck pain (HP:0030833): An unpleasant sensation characterized by physical discomfort (such as pricking, throbbing, or aching) localized to the neck. Evidence: TAS. Frequency: Very rare (HP:0040284). (ORPHA:2357)
- Abnormal lumbar spine morphology (HP:0100712): Any structural abnormality of the lumbar vertebral column. Evidence: TAS. Frequency: Very rare (HP:0040284). (ORPHA:2357)
- Atelectasis (HP:0100750): Collapse of part of a lung associated with absence of inflation (air) of that part. Evidence: TAS. Frequency: Very rare (HP:0040284). (ORPHA:2357)